Phenotypes associated with the disease intellectual developmental disorder, autosomal dominant 70 (OMIM:620157):
- Upslanted palpebral fissure (HP:0000582): The palpebral fissure inclination is more than two standard deviations above the mean for age (objective); or, the inclination of the palpebral fissure is greater than typical for age. Evidence: PCS. Frequency: 1/3. (PMID:32710489)
- Retinal detachment (HP:0000541): Separation of the inner layers of the retina (neural retina) from the pigment epithelium. Evidence: PCS. Frequency: 0/3. (PMID:32710489)
- Hearing impairment (HP:0000365): A decreased magnitude of the sensory perception of sound. Evidence: PCS. Frequency: 0/3. (PMID:32710489)
- Short palpebral fissure (HP:0012745): Distance between the medial and lateral canthi is more than 2 SD below the mean for age (objective); or, apparently reduced length of the palpebral fissures. Evidence: PCS. Frequency: 0/3. (PMID:32710489)
- Postnatal macrocephaly (HP:0005490): The postnatal development of an abnormally large skull (macrocephaly). Evidence: PCS. Frequency: 0/3. (PMID:32710489)
- Hypoplasia of the pons (HP:0012110): Underdevelopment of the pons. Evidence: PCS. Frequency: 0/3. (PMID:32710489)
- Failure to thrive (HP:0001508): Failure to thrive (FTT) refers to a child whose physical growth is substantially below the norm. Evidence: PCS. Frequency: 0/3. (PMID:32710489)
- Cataract (HP:0000518): A cataract is an opacity or clouding that develops in the crystalline lens of the eye or in its capsule. Evidence: PCS. Frequency: 0/3. (PMID:32710489)
- Overgrowth (HP:0001548): Excessive postnatal growth which may comprise increased weight, increased length, and/or increased head circumference. Evidence: PCS. Frequency: 0/3. (PMID:32710489)
- Hypertelorism (HP:0000316): Interpupillary distance more than 2 SD above the mean (alternatively, the appearance of an increased interpupillary distance or widely spaced eyes). Evidence: PCS. Frequency: 0/3. (PMID:32710489)
- Hydrocephalus (HP:0000238): Hydrocephalus is an active distension of the ventricular system of the brain resulting from inadequate passage of CSF from its point of production within the cerebral ventricles to its point of absorption into the systemic circulation. Evidence: PCS. Frequency: 0/3. (PMID:32710489)
- Retinal telangiectasia (HP:0007763): Localized, irregular dilatation of small tortuous intraretinal blood vessels. Evidence: PCS. Frequency: 0/3. (PMID:32710489)
- Low hanging columella (HP:0009765): Columella extending inferior to the level of the nasal base, when viewed from the side. Evidence: PCS. Frequency: 0/3. (PMID:32710489)
- Broad nasal tip (HP:0000455): Increase in width of the nasal tip. Evidence: PCS. Frequency: 1/3. (PMID:32710489)
- Retrognathia (HP:0000278): An abnormality in which the mandible is mislocalised posteriorly. Evidence: PCS. Frequency: 2/3. (PMID:32710489)
- Intellectual disability (HP:0001249): The term intellectual disability or intellectual developmental disorder is used to describe significantly sub-average intellectual and adaptive functioning based on clinical assessment and as measured by individually administered, appropriately normed, standardized and validated tests of intellectual functioning and adaptive behavior, with onset during the developmental period from infancy through adolescence. Evidence: PCS. Frequency: 3/3. (PMID:32710489)
- Highly arched eyebrow (HP:0002553): Increased height of the central portion of the eyebrow, forming a crescent, semicircular, or inverted U shape. Evidence: PCS. Frequency: 0/3. (PMID:32710489)
- Microcephaly (HP:0000252): Head circumference below 2 standard deviations below the mean for age and gender. Evidence: PCS. Frequency: 0/3. (PMID:32710489)
- Downslanted palpebral fissures (HP:0000494): The palpebral fissure inclination is more than two standard deviations below the mean. Evidence: PCS. Frequency: 0/3. (PMID:32710489)
- Wide nasal bridge (HP:0000431): Increased breadth of the nasal bridge (and with it, the nasal root). Evidence: PCS. Frequency: 0/3. (PMID:32710489)
- Long face (HP:0000276): Facial height (length) is more than 2 standard deviations above the mean (objective); or, an apparent increase in the height (length) of the face (subjective). Evidence: PCS. Frequency: 0/3. (PMID:32710489)
- Hypoplasia of the corpus callosum (HP:0002079): Underdevelopment of the corpus callosum. Evidence: PCS. Frequency: 0/3. (PMID:32710489)
- Feeding difficulties (HP:0011968): Impaired ability to eat related to problems gathering food and getting ready to suck, chew, or swallow it. Evidence: PCS. Frequency: 0/3. (PMID:32710489)
- Global developmental delay (HP:0001263): A delay in the achievement of motor or mental milestones in the domains of development of a child, including motor skills, speech and language, cognitive skills, and social and emotional skills. This term should only be used to describe children younger than five years of age. Evidence: PCS. Frequency: 3/3. (PMID:32710489)
- Malar flattening (HP:0000272): Underdevelopment of the malar prominence of the jugal bone (zygomatic bone in mammals), appreciated in profile, frontal view, and/or by palpation. Evidence: PCS. Frequency: 1/3. (PMID:32710489)
- Optic nerve hypoplasia (HP:0000609): Underdevelopment of the optic nerve. Evidence: PCS. Frequency: 0/3. (PMID:32710489)
- Chiari type I malformation (HP:0007099): Arnold-Chiari type I malformation refers to a relatively mild degree of herniation of the posteroinferior region of the cerebellum (the cerebellar tonsils) into the cervical canal with little or no displacement of the fourth ventricle. It is characterized by one or both pointed (not rounded) cerebellar tonsils that project 5 mm below the foramen magnum, measured by a line drawn from the basion to the opisthion (McRae Line). Evidence: PCS. Frequency: 0/3. (PMID:32710489)
- Periorbital fullness (HP:0000629): Increase in periorbital soft tissue. Evidence: PCS. Frequency: 0/3. (PMID:32710489)
- Hypoplasia of the maxilla (HP:0000327): Abnormally small dimension of the Maxilla. Usually creating a malocclusion or malalignment between the upper and lower teeth or resulting in a deficient amount of projection of the base of the nose and lower midface region. Evidence: PCS. Frequency: 0/3. (PMID:32710489)
- Hyponatremia (HP:0002902): The concentration of sodium in the blood circulation is below the lower limit of normal. Evidence: PCS. Frequency: 0/3. (PMID:32710489)
- Pointed chin (HP:0000307): A marked tapering of the lower face to the chin. Evidence: PCS. Frequency: 1/3. (PMID:32710489)
- Autosomal dominant inheritance (HP:0000006): A mode of inheritance that is observed for traits related to a gene encoded on one of the autosomes (i.e., the human chromosomes 1-22) in which a trait manifests in heterozygotes. In the context of medical genetics, an autosomal dominant disorder is caused when a single copy of the mutant allele is present. Males and females are affected equally, and can both transmit the disorder with a risk of 50% for each child of inheriting the mutant allele. Evidence: PCS. (PMID:32710489)
- Mandibular prognathia (HP:0000303): Abnormal prominence of the chin related to increased length of the mandible. Evidence: PCS. Frequency: 0/3. (PMID:32710489)
- Micrognathia (HP:0000347): Developmental hypoplasia of the mandible. Evidence: PCS. Frequency: 0/3. (PMID:32710489)